Phenotypes associated with the disease Koolen-De Vries syndrome (ORPHA:96169):
- Short stature (HP:0004322): A height below that which is expected according to age and gender norms. Although there is no universally accepted definition of short stature, many refer to "short stature" as height more than 2 standard deviations below the mean for age and gender (or below the 3rd percentile for age and gender dependent norms). Evidence: TAS. Frequency: Occasional (HP:0040283). (ORPHA:96169)
- Attention deficit hyperactivity disorder (HP:0007018): Attention deficit hyperactivity disorder (ADHD) manifests at age 2-3 years or by first grade at the latest. The main symptoms are distractibility, impulsivity, hyperactivity, and often trouble organizing tasks and projects, difficulty going to sleep, and social problems from being aggressive, loud, or impatient. Evidence: TAS. Frequency: Occasional (HP:0040283). (ORPHA:96169)
- Ichthyosis (HP:0008064): An abnormality of the skin characterized the presence of excessive amounts of dry surface scales on the skin resulting from an abnormality of keratinization. Evidence: TAS. Frequency: Occasional (HP:0040283). (ORPHA:96169)
- Stuttering (HP:0025268): Disruptions in the production of speech sounds, with involuntary repetitions of words or parts of words, prolongations of speech sounds, or complete blockage of speech production for several seconds. Evidence: TAS. Frequency: Occasional (HP:0040283). (ORPHA:96169)
- Long fingers (HP:0100807): The middle finger is more than 2 SD above the mean for newborns 27 to 41 weeks EGA or above the 97th centile for children from birth to 16 years of age AND the five digits retain their normal length proportions relative to each other (i.e., it is not the case that the middle finger is the only lengthened digit), or, Fingers that appear disproportionately long compared to the palm of the hand. Evidence: TAS. Frequency: Occasional (HP:0040283). (ORPHA:96169)
- Recurrent otitis media (HP:0000403): Increased susceptibility to otitis media, as manifested by recurrent episodes of otitis media. Evidence: TAS. Frequency: Very rare (HP:0040284). (ORPHA:96169)
- Sensorineural hearing impairment (HP:0000407): A type of hearing impairment in one or both ears related to an abnormal functionality of the cochlear nerve. Evidence: TAS. Frequency: Very rare (HP:0040284). (ORPHA:96169)
- Thick nasal alae (HP:0009928): Increase in bulk of the ala nasi. Evidence: TAS. Frequency: Very frequent (HP:0040281). (ORPHA:96169)
- Cryptorchidism (HP:0000028): Testis in inguinal canal. That is, absence of one or both testes from the scrotum owing to failure of the testis or testes to descend through the inguinal canal to the scrotum. Evidence: TAS. Frequency: Frequent (HP:0040282). (ORPHA:96169)
- Hypospadias (HP:0000047): Abnormal position of urethral meatus on the ventral penile shaft (underside) characterized by displacement of the urethral meatus from the tip of the glans penis to the ventral surface of the penis, scrotum, or perineum. Evidence: TAS. Frequency: Frequent (HP:0040282). (ORPHA:96169)
- Abnormality of the dentition (HP:0000164): Any abnormality of the teeth. Evidence: TAS. Frequency: Frequent (HP:0040282). (ORPHA:96169)
- Narrow palate (HP:0000189): Width of the palate more than 2 SD below the mean (objective) or apparently decreased palatal width (subjective). Evidence: TAS. Frequency: Frequent (HP:0040282). (ORPHA:96169)
- Strabismus (HP:0000486): A misalignment of the eyes so that the visual axes deviate from bifoveal fixation. The classification of strabismus may be based on a number of features including the relative position of the eyes, whether the deviation is latent or manifest, intermittent or constant, concomitant or otherwise and according to the age of onset and the relevance of any associated refractive error. Evidence: TAS. Frequency: Frequent (HP:0040282). (ORPHA:96169)
- Optic atrophy (HP:0000648): Atrophy of the optic nerve. Optic atrophy results from the death of the retinal ganglion cell axons that comprise the optic nerve and manifesting as a pale optic nerve on fundoscopy. Evidence: TAS. Frequency: Frequent (HP:0040282). (ORPHA:96169)
- Microdontia (HP:0000691): Decreased size of the teeth, which can be defined as a mesiodistal tooth diameter (width) more than 2 SD below mean. Alternatively, an apparently decreased maximum width of tooth. Evidence: TAS. Frequency: Frequent (HP:0040282). (ORPHA:96169)
- Delayed speech and language development (HP:0000750): A degree of language development that is significantly below the norm for a child of a specified age. Evidence: TAS. Frequency: Frequent (HP:0040282). (ORPHA:96169)
- Arachnodactyly (HP:0001166): Abnormally long and slender fingers (spider fingers). Evidence: TAS. Frequency: Frequent (HP:0040282). (ORPHA:96169)
- Seizure (HP:0001250): A seizure is an intermittent abnormality of nervous system physiology characterized by a transient occurrence of signs and/or symptoms due to abnormal excessive or synchronous neuronal activity in the brain. Evidence: TAS. Frequency: Frequent (HP:0040282). (ORPHA:96169)
- Joint hypermobility (HP:0001382): The capability that a joint (or a group of joints) has to move, passively and/or actively, beyond normal limits along physiological axes. Evidence: TAS. Frequency: Frequent (HP:0040282). (ORPHA:96169)
- Hypernasal speech (HP:0001611): A type of speech characterized by the presence of an abnormally increased nasal airflow during speech associated with structural abnormality of the nasal passages. Evidence: TAS. Frequency: Frequent (HP:0040282). (ORPHA:96169)
- Abnormal heart morphology (HP:0001627): Any structural anomaly of the heart. Evidence: TAS. Frequency: Frequent (HP:0040282). (ORPHA:96169)
- Ventricular septal defect (HP:0001629): A hole between the two bottom chambers (ventricles) of the heart. The defect is centered around the most superior aspect of the ventricular septum. Evidence: TAS. Frequency: Frequent (HP:0040282). (ORPHA:96169)
- Atrial septal defect (HP:0001631): Atrial septal defect (ASD) is a congenital abnormality of the interatrial septum that enables blood flow between the left and right atria via the interatrial septum. Evidence: TAS. Frequency: Frequent (HP:0040282). (ORPHA:96169)
- Cardiomyopathy (HP:0001638): A myocardial disorder in which the heart muscle is structurally and functionally abnormal, in the absence of coronary artery disease, hypertension, valvular disease and congenital heart disease sufficient to cause the observed myocardial abnormality. Evidence: TAS. Frequency: Frequent (HP:0040282). (ORPHA:96169)
- Abnormal cardiac septum morphology (HP:0001671): An anomaly of the intra-atrial or intraventricular septum. Evidence: TAS. Frequency: Frequent (HP:0040282). (ORPHA:96169)
- Ventriculomegaly (HP:0002119): An increase in size of the ventricular system of the brain. Evidence: TAS. Frequency: Frequent (HP:0040282). (ORPHA:96169)
- Poor speech (HP:0002465). Evidence: TAS. Frequency: Frequent (HP:0040282). (ORPHA:96169)
- High, narrow palate (HP:0002705): The presence of a high and narrow palate. Evidence: TAS. Frequency: Frequent (HP:0040282). (ORPHA:96169)
- Hip dislocation (HP:0002827): Displacement of the femur from its normal location in the hip joint. Evidence: TAS. Frequency: Frequent (HP:0040282). (ORPHA:96169)
- Hypopigmentation of hair (HP:0005599). Evidence: TAS. Frequency: Frequent (HP:0040282). (ORPHA:96169)
- Chiari type I malformation (HP:0007099): Arnold-Chiari type I malformation refers to a relatively mild degree of herniation of the posteroinferior region of the cerebellum (the cerebellar tonsils) into the cervical canal with little or no displacement of the fourth ventricle. It is characterized by one or both pointed (not rounded) cerebellar tonsils that project 5 mm below the foramen magnum, measured by a line drawn from the basion to the opisthion (McRae Line). Evidence: TAS. Frequency: Frequent (HP:0040282). (ORPHA:96169)
- Aplasia/Hypoplasia of the corpus callosum (HP:0007370): Absence or underdevelopment of the corpus callosum. Evidence: TAS. Frequency: Frequent (HP:0040282). (ORPHA:96169)
- High hypermetropia (HP:0008499): A severe form of hypermetropia with over +5.00 diopters. Evidence: TAS. Frequency: Frequent (HP:0040282). (ORPHA:96169)
- Feeding difficulties in infancy (HP:0008872): Impaired feeding performance of an infant as manifested by difficulties such as weak and ineffective sucking, brief bursts of sucking, and falling asleep during sucking. There may be difficulties with chewing or maintaining attention. Evidence: TAS. Frequency: Frequent (HP:0040282). (ORPHA:96169)
- Abnormality of hair texture (HP:0010719): An abnormality of the texture of the hair. Evidence: TAS. Frequency: Frequent (HP:0040282). (ORPHA:96169)
- Intraventricular hemorrhage (HP:0030746): Bleeding into the ventricles of the brain. Evidence: TAS. Frequency: Frequent (HP:0040282). (ORPHA:96169)
- Overfriendliness (HP:0100025): A form of hypersociability that presents as mostly inappropriate friendliness towards others. Evidence: TAS. Frequency: Frequent (HP:0040282). (ORPHA:96169)
- Ureteral duplication (HP:0000073): A developmental anomaly characterized by the presence of two, instead of one, ureter connecting a kidney to the bladder. Evidence: TAS. Frequency: Occasional (HP:0040283). (ORPHA:96169)
- Renal duplication (HP:0000075): A congenital anomaly of the urinary tract, in which the kidney is duplicated and is drained via two separate renal pelves and ureters. Evidence: TAS. Frequency: Occasional (HP:0040283). (ORPHA:96169)
- Vesicoureteral reflux (HP:0000076): Abnormal (retrograde) movement of urine from the bladder into ureters or kidneys related to inadequacy of the valvular mechanism at the ureterovesicular junction or other causes. Evidence: TAS. Frequency: Occasional (HP:0040283). (ORPHA:96169)
- Hydronephrosis (HP:0000126): Severe distention of the kidney with dilation of the renal pelvis and calices. Evidence: TAS. Frequency: Occasional (HP:0040283). (ORPHA:96169)
- Cleft palate (HP:0000175): Cleft palate is a developmental defect of the palate resulting from a failure of fusion of the palatine processes and manifesting as a separation of the roof of the mouth (soft and hard palate). Evidence: TAS. Frequency: Occasional (HP:0040283). (ORPHA:96169)
- Microcephaly (HP:0000252): Head circumference below 2 standard deviations below the mean for age and gender. Evidence: TAS. Frequency: Occasional (HP:0040283). (ORPHA:96169)
- Conductive hearing impairment (HP:0000405): An abnormality of vibrational conductance of sound to the inner ear leading to impairment of sensory perception of sound. Evidence: TAS. Frequency: Occasional (HP:0040283). (ORPHA:96169)
- Cataract (HP:0000518): A cataract is an opacity or clouding that develops in the crystalline lens of the eye or in its capsule. Evidence: TAS. Frequency: Occasional (HP:0040283). (ORPHA:96169)
- Hypodontia (HP:0000668): The absence of five or less teeth from the normal series by a failure to develop. Evidence: TAS. Frequency: Occasional (HP:0040283). (ORPHA:96169)
- Abnormal dental enamel morphology (HP:0000682): An abnormality of the dental enamel. Evidence: TAS. Frequency: Occasional (HP:0040283). (ORPHA:96169)
- Anxiety (HP:0000739): Intense feelings of nervousness, tension, or panic often arise in response to interpersonal stresses. There is worry about the negative effects of past unpleasant experiences and future negative possibilities. Individuals may feel fearful, apprehensive, or threatened by uncertainty, and they may also have fears of falling apart or losing control. Evidence: TAS. Frequency: Occasional (HP:0040283). (ORPHA:96169)
- Pectus excavatum (HP:0000767): A defect of the chest wall characterized by a depression of the sternum, giving the chest ("pectus") a caved-in ("excavatum") appearance. Evidence: TAS. Frequency: Occasional (HP:0040283). (ORPHA:96169)
- Hypothyroidism (HP:0000821): Deficiency of thyroid hormone. Evidence: TAS. Frequency: Occasional (HP:0040283). (ORPHA:96169)
- Cafe-au-lait spot (HP:0000957): Cafe-au-lait spots are hyperpigmented lesions that can vary in color from light brown to dark brown with smooth borders and having a size of 1.5 cm or more in adults and 0.5 cm or more in children. Evidence: TAS. Frequency: Occasional (HP:0040283). (ORPHA:96169)
- Dry skin (HP:0000958): Skin characterized by the lack of natural or normal moisture. Evidence: TAS. Frequency: Occasional (HP:0040283). (ORPHA:96169)
- Sacral dimple (HP:0000960): A cutaneous indentation resulting from tethering of the skin to underlying structures (bone) of the intergluteal cleft. Evidence: TAS. Frequency: Occasional (HP:0040283). (ORPHA:96169)
- Hemangioma (HP:0001028): A hemangioma is a benign tumor characterized by blood-filled spaces lined by benign endothelial cells. A hemangioma characterized by large endothelial spaces (caverns) is called a cavernous hemangioma (in contrast to a hemangioma with small endothelial spaces, which is called capillary hemangioma). Evidence: TAS. Frequency: Occasional (HP:0040283). (ORPHA:96169)
- Numerous nevi (HP:0001054). Evidence: TAS. Frequency: Occasional (HP:0040283). (ORPHA:96169)
- Laryngomalacia (HP:0001601): Laryngomalacia is a congenital abnormality of the laryngeal cartilage in which the cartilage is floppy and prolapses over the larynx during inspiration. Evidence: TAS. Frequency: Occasional (HP:0040283). (ORPHA:96169)
- Bicuspid aortic valve (HP:0001647): The presence of an aortic valve with two instead of the normal three cusps (flaps). Bicuspid aortic valvue is a malformation of a commissure (small space between the attachment of each cusp to the aortic wall) and the adjacent parts of the two corresponding cusps forming a raphe (the fused area of the two underdeveloped cusps turning into a malformed commissure between both cusps; the raphe is a fibrous ridge that extends from the commissure to the free edge of the two underdeveloped, conjoint cusps). Evidence: TAS. Frequency: Occasional (HP:0040283). (ORPHA:96169)
- Pes planus (HP:0001763): A foot where the longitudinal arch of the foot is in contact with the ground or floor when the individual is standing; or, in a patient lying supine, a foot where the arch is in contact with the surface of a flat board pressed against the sole of the foot by the examiner with a pressure similar to that expected from weight bearing; or, the height of the arch is reduced. Evidence: TAS. Frequency: Occasional (HP:0040283). (ORPHA:96169)
- Pyloric stenosis (HP:0002021): Pyloric stenosis, also known as infantile hypertrophic pyloric stenosis, is an uncommon condition in infants characterized by abnormal thickening of the pylorus muscles in the stomach leading to gastric outlet obstruction. Clinically infants are well at birth. Then, at 3 to 6 weeks of age, the infants present with projectile vomiting, potentially leading to dehydration and weight loss. Evidence: TAS. Frequency: Occasional (HP:0040283). (ORPHA:96169)
- Spina bifida (HP:0002414): Incomplete closure of the embryonic neural tube, whereby some vertebral arches remain unfused and open. The mildest form is spina bifida occulta, followed by meningocele and meningomyelocele. Evidence: TAS. Frequency: Occasional (HP:0040283). (ORPHA:96169)
- Scoliosis (HP:0002650): The presence of an abnormal lateral curvature of the spine. Evidence: TAS. Frequency: Occasional (HP:0040283). (ORPHA:96169)
- Kyphosis (HP:0002808): Exaggerated anterior convexity of the thoracic vertebral column. Evidence: TAS. Frequency: Occasional (HP:0040283). (ORPHA:96169)
- Vertebral fusion (HP:0002948): A developmental defect leading to the union of two adjacent vertebrae. Evidence: TAS. Frequency: Occasional (HP:0040283). (ORPHA:96169)
- Vertebral segmentation defect (HP:0003422): An abnormality related to a defect of vertebral separation during development. Evidence: TAS. Frequency: Occasional (HP:0040283). (ORPHA:96169)
- Everted lower lip vermilion (HP:0000232): An abnormal configuration of the lower lip such that it is turned outward i.e., everted, with the Inner aspect of the lower lip vermilion (normally opposing the teeth) being visible in a frontal view. Evidence: TAS. Frequency: Very frequent (HP:0040281). (ORPHA:96169)
- Long face (HP:0000276): Facial height (length) is more than 2 standard deviations above the mean (objective); or, an apparent increase in the height (length) of the face (subjective). Evidence: TAS. Frequency: Very frequent (HP:0040281). (ORPHA:96169)
- Coarse facial features (HP:0000280): Absence of fine and sharp appearance of brows, nose, lips, mouth, and chin, usually because of rounded and heavy features or thickened skin with or without thickening of subcutaneous and bony tissues. Evidence: TAS. Frequency: Very frequent (HP:0040281). (ORPHA:96169)
- Epicanthus (HP:0000286): A fold of skin starting above the medial aspect of the upper eyelid and arching downward to cover, pass in front of and lateral to the medial canthus. Evidence: TAS. Frequency: Very frequent (HP:0040281). (ORPHA:96169)
- Broad forehead (HP:0000337): Width of the forehead or distance between the frontotemporales is more than two standard deviations above the mean (objective); or apparently increased distance between the two sides of the forehead. Evidence: TAS. Frequency: Very frequent (HP:0040281). (ORPHA:96169)
- High forehead (HP:0000348): An abnormally increased height of the forehead. Evidence: TAS. Frequency: Very frequent (HP:0040281). (ORPHA:96169)
- Overfolded helix (HP:0000396): A condition in which the helix is folded over to a greater degree than normal. That is, excessive curling of the helix edge, whereby the free edge is parallel to the plane of the ear. Evidence: TAS. Frequency: Very frequent (HP:0040281). (ORPHA:96169)
- Protruding ear (HP:0000411): Angle formed by the plane of the ear and the mastoid bone greater than the 97th centile for age (objective); or, outer edge of the helix more than 2 cm from the mastoid at the point of maximum distance (objective). Evidence: TAS. Frequency: Very frequent (HP:0040281). (ORPHA:96169)
- Bulbous nose (HP:0000414): Increased volume and globular shape of the anteroinferior aspect of the nose. Evidence: TAS. Frequency: Very frequent (HP:0040281). (ORPHA:96169)
- Prominent nasal bridge (HP:0000426): Anterior positioning of the nasal root in comparison to the usual positioning for age. Evidence: TAS. Frequency: Very frequent (HP:0040281). (ORPHA:96169)
- Underdeveloped nasal alae (HP:0000430): Thinned, deficient, or excessively arched ala nasi. Evidence: TAS. Frequency: Very frequent (HP:0040281). (ORPHA:96169)
- Wide nasal bridge (HP:0000431): Increased breadth of the nasal bridge (and with it, the nasal root). Evidence: TAS. Frequency: Very frequent (HP:0040281). (ORPHA:96169)
- Ptosis (HP:0000508): The upper eyelid margin is positioned 3 mm or more lower than usual and covers the superior portion of the iris (objective); or, the upper lid margin obscures at least part of the pupil (subjective). Evidence: TAS. Frequency: Very frequent (HP:0040281). (ORPHA:96169)
- Blepharophimosis (HP:0000581): A fixed reduction in the vertical distance between the upper and lower eyelids with short palpebral fissures. Evidence: TAS. Frequency: Very frequent (HP:0040281). (ORPHA:96169)
- Upslanted palpebral fissure (HP:0000582): The palpebral fissure inclination is more than two standard deviations above the mean for age (objective); or, the inclination of the palpebral fissure is greater than typical for age. Evidence: TAS. Frequency: Very frequent (HP:0040281). (ORPHA:96169)
- Intellectual disability (HP:0001249): The term intellectual disability or intellectual developmental disorder is used to describe significantly sub-average intellectual and adaptive functioning based on clinical assessment and as measured by individually administered, appropriately normed, standardized and validated tests of intellectual functioning and adaptive behavior, with onset during the developmental period from infancy through adolescence. Evidence: TAS. Frequency: Very frequent (HP:0040281). (ORPHA:96169)
- Hypotonia (HP:0001252): Hypotonia is an abnormally low muscle tone (the amount of tension or resistance to movement in a muscle). Even when relaxed, muscles have a continuous and passive partial contraction which provides some resistance to passive stretching. Hypotonia thus manifests as diminished resistance to passive stretching. Hypotonia is not the same as muscle weakness, although the two conditions can co-exist. Evidence: TAS. Frequency: Very frequent (HP:0040281). (ORPHA:96169)
- Global developmental delay (HP:0001263): A delay in the achievement of motor or mental milestones in the domains of development of a child, including motor skills, speech and language, cognitive skills, and social and emotional skills. This term should only be used to describe children younger than five years of age. Evidence: TAS. Frequency: Very frequent (HP:0040281). (ORPHA:96169)